Phenotypes associated with the disease myoclonus-cerebellar ataxia-deafness syndrome (OMIM:159800):
- Hearing impairment (HP:0000365): A decreased magnitude of the sensory perception of sound. Evidence: IEA. (OMIM:159800)
- Ataxia (HP:0001251): Ataxia refers to impaired coordination of voluntary muscle movement. Cerebellar ataxia refers to ataxia due to dysfunction of the cerebellum. This causes a variety of elementary neurological deficits including asynergy (lack of coordination between muscles, limbs and joints), dysmetria (lack of ability to judge distances that can lead to under- or overshoot in grasping movements), and dysdiadochokinesia (inability to perform rapid movements requiring antagonizing muscle groups to be switched on and off repeatedly). Evidence: IEA. (OMIM:159800)
- Autosomal dominant inheritance (HP:0000006): A mode of inheritance that is observed for traits related to a gene encoded on one of the autosomes (i.e., the human chromosomes 1-22) in which a trait manifests in heterozygotes. In the context of medical genetics, an autosomal dominant disorder is caused when a single copy of the mutant allele is present. Males and females are affected equally, and can both transmit the disorder with a risk of 50% for each child of inheriting the mutant allele. Evidence: IEA. (OMIM:159800)
- Myoclonus (HP:0001336): Very brief, involuntary random muscular contractions occurring at rest, in response to sensory stimuli, or accompanying voluntary movements. Evidence: IEA. (OMIM:159800)